Phenotypes associated with the disease combined oxidative phosphorylation deficiency 49 (OMIM:619024):
- Progressive muscle weakness (HP:0003323). Evidence: PCS. Frequency: 1/1. (PMID:29361167)
- Elevated circulating creatine kinase activity (HP:0003236): The activity of creatine kinase in the blood circulation is above the upper limit of normal. Evidence: PCS. Frequency: 1/1. (PMID:29361167)
- Juvenile onset (HP:0003621): Onset of signs or symptoms of disease between the age of 5 and 15 years. Evidence: PCS. Frequency: 1/1. (PMID:29361167)
- Ragged-red muscle fibers (HP:0003200): An abnormal appearance of muscle fibers observed on muscle biopsy. Ragged red fibers can be visualized with Gomori trichrome staining as irregular and intensely red subsarcolemmal zones, whereas the normal myofibrils are green. The margins of affect fibers appear red and ragged. The ragged-red is due to the accumulation of abnormal mitochondria below the plasma membrane of the muscle fiber, leading to the appearance of a red rim and speckled sarcoplasm. Evidence: PCS. Frequency: 1/1. (PMID:29361167)
- Gait disturbance (HP:0001288): The term gait disturbance can refer to any disruption of the ability to walk. Evidence: PCS. Frequency: 1/1. (PMID:29361167)
- Decreased activity of mitochondrial complex III (HP:0011924): A reduction in the activity of the mitochondrial respiratory chain complex III, which is part of the electron transport chain in mitochondria. Evidence: PCS. Frequency: 1/1. (PMID:29361167)
- Difficulty climbing stairs (HP:0003551): Reduced ability to climb stairs. Evidence: PCS. Frequency: 1/1. (PMID:29361167)
- Decreased activity of mitochondrial complex I (HP:0011923): A reduction in the activity of the mitochondrial respiratory chain complex I, which is part of the electron transport chain in mitochondria. Evidence: PCS. Frequency: 1/1. (PMID:29361167)
- Autosomal recessive inheritance (HP:0000007): A mode of inheritance that is observed for traits related to a gene encoded on one of the autosomes (i.e., the human chromosomes 1-22) in which a trait manifests in individuals with two pathogenic alleles, either homozygotes (two copies of the same mutant allele) or compound heterozygotes (whereby each copy of a gene has a distinct mutant allele). Evidence: PCS. (PMID:29361167)
- Decreased activity of mitochondrial complex IV (HP:0008347): A reduction in the activity of the mitochondrial respiratory chain complex IV, which is part of the electron transport chain in mitochondria. Evidence: PCS. Frequency: 1/1. (PMID:29361167)
- Decreased activity of mitochondrial complex II (HP:0008314): A reduction in the activity of the mitochondrial respiratory chain complex II, which is part of the electron transport chain in mitochondria. Evidence: PCS. Frequency: 1/1. (PMID:29361167)
- Cytochrome C oxidase-negative muscle fibers (HP:0003688): An abnormally reduced activity of the enzyme cytochrome C oxidase in muscle tissue. Evidence: PCS. Frequency: 1/1. (PMID:29361167)
- Myalgia (HP:0003326): Pain in muscle. Evidence: PCS. Frequency: 1/1. (PMID:29361167)
- Exercise intolerance (HP:0003546): A functional motor deficit where individuals whose responses to the challenges of exercise fail to achieve levels considered normal for their age and gender. Evidence: PCS. Frequency: 1/1. (PMID:29361167)